Phenotypes associated with the disease Char syndrome (ORPHA:46627):
- Agenesis of permanent teeth (HP:0006349): A congenital defect characterized by the absence of one or more permanent teeth, including oligodontia, hypodontia, and adontia of the of permanent teeth. Evidence: TAS. Frequency: Occasional (HP:0040283). (ORPHA:46627)
- Triangular mouth (HP:0000207): The presence of a triangular form of the mouth. Evidence: TAS. Frequency: Very frequent (HP:0040281). (ORPHA:46627)
- Everted lower lip vermilion (HP:0000232): An abnormal configuration of the lower lip such that it is turned outward i.e., everted, with the Inner aspect of the lower lip vermilion (normally opposing the teeth) being visible in a frontal view. Evidence: TAS. Frequency: Very frequent (HP:0040281). (ORPHA:46627)
- Malar flattening (HP:0000272): Underdevelopment of the malar prominence of the jugal bone (zygomatic bone in mammals), appreciated in profile, frontal view, and/or by palpation. Evidence: TAS. Frequency: Very frequent (HP:0040281). (ORPHA:46627)
- Hypertelorism (HP:0000316): Interpupillary distance more than 2 SD above the mean (alternatively, the appearance of an increased interpupillary distance or widely spaced eyes). Evidence: TAS. Frequency: Very frequent (HP:0040281). (ORPHA:46627)
- Short philtrum (HP:0000322): Distance between nasal base and midline upper lip vermilion border more than 2 SD below the mean. Alternatively, an apparently decreased distance between nasal base and midline upper lip vermilion border. Evidence: TAS. Frequency: Very frequent (HP:0040281). (ORPHA:46627)
- Depressed nasal ridge (HP:0000457): Lack of prominence of the nose resulting from a posteriorly-placed nasal ridge. Evidence: TAS. Frequency: Very frequent (HP:0040281). (ORPHA:46627)
- Downslanted palpebral fissures (HP:0000494): The palpebral fissure inclination is more than two standard deviations below the mean. Evidence: TAS. Frequency: Very frequent (HP:0040281). (ORPHA:46627)
- Ptosis (HP:0000508): The upper eyelid margin is positioned 3 mm or more lower than usual and covers the superior portion of the iris (objective); or, the upper lid margin obscures at least part of the pupil (subjective). Evidence: TAS. Frequency: Very frequent (HP:0040281). (ORPHA:46627)
- Patent ductus arteriosus (HP:0001643): In utero, the ductus arteriosus (DA) serves to divert ventricular output away from the lungs and toward the placenta by connecting the main pulmonary artery to the descending aorta. A patent ductus arteriosus (PDA) in the first 3 days of life is a physiologic shunt in healthy term and preterm newborn infants, and normally is substantially closed within about 24 hours after bith and completely closed after about three weeks. Failure of physiologcal closure is referred to a persistent or patent ductus arteriosus (PDA). Depending on the degree of left-to-right shunting, PDA can have clinical consequences. Evidence: TAS. Frequency: Very frequent (HP:0040281). (ORPHA:46627)
- Depressed nasal bridge (HP:0005280): Posterior positioning of the nasal root in relation to the overall facial profile for age. Evidence: TAS. Frequency: Very frequent (HP:0040281). (ORPHA:46627)
- Thick vermilion border (HP:0012471): Increased width of the skin of vermilion border region of upper lip. Evidence: TAS. Frequency: Very frequent (HP:0040281). (ORPHA:46627)
- Clinodactyly of the 5th finger (HP:0004209): Clinodactyly refers to a bending or curvature of the fifth finger in the radial direction (i.e., towards the 4th finger). Evidence: TAS. Frequency: Frequent (HP:0040282). (ORPHA:46627)
- Short middle phalanx of the 5th finger (HP:0004220): Hypoplastic/small middle phalanx of the fifth finger. Evidence: TAS. Frequency: Frequent (HP:0040282). (ORPHA:46627)
- Mesoaxial hand polydactyly (HP:0006159): The presence of a supernumerary finger (not a thumb) involving the third or fourth metacarpal with associated osseous syndactyly. Evidence: TAS. Frequency: Frequent (HP:0040282). (ORPHA:46627)
- Prominent occiput (HP:0000269): Increased convexity of the occiput (posterior part of the skull). Evidence: TAS. Frequency: Occasional (HP:0040283). (ORPHA:46627)
- Hearing impairment (HP:0000365): A decreased magnitude of the sensory perception of sound. Evidence: TAS. Frequency: Occasional (HP:0040283). (ORPHA:46627)
- Strabismus (HP:0000486): A misalignment of the eyes so that the visual axes deviate from bifoveal fixation. The classification of strabismus may be based on a number of features including the relative position of the eyes, whether the deviation is latent or manifest, intermittent or constant, concomitant or otherwise and according to the age of onset and the relevance of any associated refractive error. Evidence: TAS. Frequency: Occasional (HP:0040283). (ORPHA:46627)
- Myopia (HP:0000545): An abnormality of refraction characterized by the ability to see objects nearby clearly, while objects in the distance appear blurry. Evidence: TAS. Frequency: Occasional (HP:0040283). (ORPHA:46627)
- Hand polydactyly (HP:0001161): A kind of polydactyly characterized by the presence of a supernumerary finger or fingers. Evidence: TAS. Frequency: Occasional (HP:0040283). (ORPHA:46627)
- Global developmental delay (HP:0001263): A delay in the achievement of motor or mental milestones in the domains of development of a child, including motor skills, speech and language, cognitive skills, and social and emotional skills. This term should only be used to describe children younger than five years of age. Evidence: TAS. Frequency: Occasional (HP:0040283). (ORPHA:46627)
- Ventricular septal defect (HP:0001629): A hole between the two bottom chambers (ventricles) of the heart. The defect is centered around the most superior aspect of the ventricular septum. Evidence: TAS. Frequency: Occasional (HP:0040283). (ORPHA:46627)
- Toe syndactyly (HP:0001770): Webbing or fusion of the toes, involving soft parts only or including bone structure. Bony fusions are referred to as "bony" Syndactyly if the fusion occurs in a radio-ulnar axis. Fusions of bones of the toes in a proximo-distal axis are referred to as "Symphalangism". Evidence: TAS. Frequency: Occasional (HP:0040283). (ORPHA:46627)
- Sleep disturbance (HP:0002360): An abnormal pattern in the quality, quantity, or characteristics of sleep. Evidence: TAS. Frequency: Occasional (HP:0040283). (ORPHA:46627)
- Supernumerary nipple (HP:0002558): Presence of more than two nipples. Evidence: TAS. Frequency: Occasional (HP:0040283). (ORPHA:46627)
- Fifth finger symphalangism (HP:0004218): Congenital bony fusion of two adjacent phalanges of the fifth finger. Evidence: TAS. Frequency: Occasional (HP:0040283). (ORPHA:46627)
- Persistence of primary teeth (HP:0006335): Persistence of the primary teeth beyond the age by which they normally are shed and replaced by the permanent teeth. Evidence: TAS. Frequency: Occasional (HP:0040283). (ORPHA:46627)
- Mesoaxial foot polydactyly (HP:0010112): The presence of a supernumerary toe (not a hallux) involving the third or fourth metatarsal with associated osseous syndactyly. Evidence: TAS. Frequency: Occasional (HP:0040283). (ORPHA:46627)